- Abnormality of metabolism/homeostasis (HP:0001939). Evidence: IEA. (OMIM:212800)
- Autosomal recessive inheritance (HP:0000007): A mode of inheritance that is observed for traits related to a gene encoded on one of the autosomes (i.e., the human chromosomes 1-22) in which a trait manifests in individuals with two pathogenic alleles, either homozygotes (two copies of the same mutant allele) or compound heterozygotes (whereby each copy of a gene has a distinct mutant allele). Evidence: IEA. (OMIM:212800)
- Intellectual disability (HP:0001249): The term intellectual disability or intellectual developmental disorder is used to describe significantly sub-average intellectual and adaptive functioning based on clinical assessment and as measured by individually administered, appropriately normed, standardized and validated tests of intellectual functioning and adaptive behavior, with onset during the developmental period from infancy through adolescence. Evidence: IEA. (OMIM:212800)
- Abnormality of the spleen (HP:0001743): An abnormality of the spleen. Evidence: IEA. (OMIM:212800)
These phenotypes are associated with the disease cephalin lipidosis (OMIM:212800).